Phenotypes associated with the disease Rh-null disease, amorph type (OMIM:617970):
- Increased red cell osmotic fragility (HP:0005502). Evidence: TAS. (OMIM:617970)
- Stomatocytosis (HP:0004446): The presence of erythrocytes with a mouth-shaped (stoma) area of central pallor on peripheral blood smear. Evidence: TAS. (OMIM:617970)
- Anisocytosis (HP:0011273): Abnormally increased variability in the size of erythrocytes. Evidence: TAS. (OMIM:617970)
- Hyperbilirubinemia (HP:0002904): An increased amount of bilirubin in the blood. Evidence: TAS. (OMIM:617970)
- Hemolytic anemia (HP:0001878): A type of anemia caused by premature destruction of red blood cells (hemolysis). Evidence: PCS. Frequency: 1/1. (PMID:25413218)
- Autosomal recessive inheritance (HP:0000007): A mode of inheritance that is observed for traits related to a gene encoded on one of the autosomes (i.e., the human chromosomes 1-22) in which a trait manifests in individuals with two pathogenic alleles, either homozygotes (two copies of the same mutant allele) or compound heterozygotes (whereby each copy of a gene has a distinct mutant allele). Evidence: PCS. (PMID:9657769)
- Reticulocytosis (HP:0001923): An elevation in the number of reticulocytes (immature erythrocytes) in the peripheral blood circulation. Evidence: TAS. (OMIM:617970)